Phenotypes associated with the disease autosomal recessive nonsyndromic hearing loss 91 (OMIM:613453):
- Autosomal recessive inheritance (HP:0000007): A mode of inheritance that is observed for traits related to a gene encoded on one of the autosomes (i.e., the human chromosomes 1-22) in which a trait manifests in individuals with two pathogenic alleles, either homozygotes (two copies of the same mutant allele) or compound heterozygotes (whereby each copy of a gene has a distinct mutant allele). Evidence: TAS. (OMIM:613453)
- Progressive hearing impairment (HP:0001730): A progressive form of hearing impairment. Evidence: TAS. (OMIM:613453)